Phenotypes associated with the disease respiratory distress syndrome in premature infants (OMIM:267450, an entry in Online Mendelian Inheritance in Man):
- Congenital onset (HP:0003577, a Human Phenotype Ontology term): A phenotypic abnormality that is present at birth. Evidence: IEA. (OMIM:267450)
- Pulmonary edema (HP:0100598, a Human Phenotype Ontology term): Fluid accumulation in the lungs. Evidence: IEA. (OMIM:267450)
- Disseminated intravascular coagulation (HP:0005521, a Human Phenotype Ontology term): Disseminated intravascular coagulation is characterized by the widespread activation of coagulation, which results in the intravascular formation of fibrin and ultimately thrombotic occlusion of small and midsize vessels. Evidence: IEA. (OMIM:267450)
- Edema (HP:0000969, a Human Phenotype Ontology term): An abnormal accumulation of fluid beneath the skin, or in one or more cavities of the body. Evidence: IEA. (OMIM:267450)
- Respiratory distress (HP:0002098, a Human Phenotype Ontology term): Respiratory distress is objectively observable as the physical or emotional consequences from the experience of dyspnea. The physical presentation of respiratory distress is generally referred to as labored breathing, while the sensation of respiratory distress is called shortness of breath or dyspnea. Evidence: IEA. (OMIM:267450)
- Dyspnea (HP:0002094, a Human Phenotype Ontology term): Difficult or labored breathing. Dyspnea is a subjective feeling only the patient can rate, e.g., on a Borg scale. Evidence: IEA. (OMIM:267450)
- Non-Mendelian inheritance (HP:0001426, a Human Phenotype Ontology term): A mode of inheritance that depends on genetic determinants in more than one gene. Evidence: IEA. (OMIM:267450)
- Sporadic (HP:0003745, a Human Phenotype Ontology term): Cases of the disease in question occur without a previous family history, i.e., as isolated cases without being transmitted from a parent and without other siblings being affected. Evidence: IEA. (OMIM:267450)
- Atelectasis (HP:0100750, a Human Phenotype Ontology term): Collapse of part of a lung associated with absence of inflation (air) of that part. Evidence: TAS. (OMIM:267450)
- Tachypnea (HP:0002789, a Human Phenotype Ontology term): Very rapid breathing. Evidence: IEA. (OMIM:267450)
- Neonatal respiratory distress (HP:0002643, a Human Phenotype Ontology term): Respiratory difficulty as newborn. Evidence: IEA. (OMIM:267450)
- Premature birth (HP:0001622, a Human Phenotype Ontology term): The birth of a baby of less than 37 weeks of gestational age. Evidence: IEA. (OMIM:267450)